Phenotypes associated with the disease Ocular motor apraxia, Cogan type (ORPHA:1125):
- Oculomotor apraxia (HP:0000657): Ocular motor apraxia is a deficiency in voluntary, horizontal, lateral, fast eye movements (saccades) with retention of slow pursuit movements. The inability to follow objects visually is often compensated by head movements. There may be decreased smooth pursuit, and cancelation of the vestibulo-ocular reflex. Evidence: TAS. Frequency: Very frequent (HP:0040281). (ORPHA:1125)
- Ataxia (HP:0001251): Ataxia refers to impaired coordination of voluntary muscle movement. Cerebellar ataxia refers to ataxia due to dysfunction of the cerebellum. This causes a variety of elementary neurological deficits including asynergy (lack of coordination between muscles, limbs and joints), dysmetria (lack of ability to judge distances that can lead to under- or overshoot in grasping movements), and dysdiadochokinesia (inability to perform rapid movements requiring antagonizing muscle groups to be switched on and off repeatedly). Evidence: TAS. Frequency: Very frequent (HP:0040281). (ORPHA:1125)
- Delayed speech and language development (HP:0000750): A degree of language development that is significantly below the norm for a child of a specified age. Evidence: TAS. Frequency: Frequent (HP:0040282). (ORPHA:1125)
- Impaired horizontal smooth pursuit (HP:0001151): An abnormality of ocular smooth pursuit characterized by an impairment of the ability to track horizontally moving objects. Evidence: TAS. Frequency: Frequent (HP:0040282). (ORPHA:1125)
- Motor delay (HP:0001270): A type of Developmental delay characterized by a delay in acquiring motor skills. Evidence: TAS. Frequency: Frequent (HP:0040282). (ORPHA:1125)
- Specific learning disability (HP:0001328): Impairment of certain skills such as reading or writing, coordination, self-control, or attention that interfere with the ability to learn. The impairment is not related to a global deficiency of intelligence. Evidence: TAS. Frequency: Frequent (HP:0040282). (ORPHA:1125)
- Molar tooth sign on MRI (HP:0002419): An abnormal appearance of the midbrain in axial magnetic resonance imaging in which the elongated superior cerebellar peduncles give the midbrain an appearance reminiscent of a molar or wisdom tooth. Evidence: TAS. Frequency: Frequent (HP:0040282). (ORPHA:1125)
- Aplasia/Hypoplasia of the cerebellar vermis (HP:0006817): Absence or underdevelopment of the vermis of cerebellum. Evidence: TAS. Frequency: Frequent (HP:0040282). (ORPHA:1125)
- Jerky head movements (HP:0006961). Evidence: TAS. Frequency: Frequent (HP:0040282). (ORPHA:1125)
- Strabismus (HP:0000486): A misalignment of the eyes so that the visual axes deviate from bifoveal fixation. The classification of strabismus may be based on a number of features including the relative position of the eyes, whether the deviation is latent or manifest, intermittent or constant, concomitant or otherwise and according to the age of onset and the relevance of any associated refractive error. Evidence: TAS. Frequency: Occasional (HP:0040283). (ORPHA:1125)
- Nystagmus (HP:0000639): Rhythmic, involuntary oscillations of one or both eyes related to abnormality in fixation, conjugate gaze, or vestibular mechanisms. Evidence: TAS. Frequency: Occasional (HP:0040283). (ORPHA:1125)
- Intellectual disability (HP:0001249): The term intellectual disability or intellectual developmental disorder is used to describe significantly sub-average intellectual and adaptive functioning based on clinical assessment and as measured by individually administered, appropriately normed, standardized and validated tests of intellectual functioning and adaptive behavior, with onset during the developmental period from infancy through adolescence. Evidence: TAS. Frequency: Occasional (HP:0040283). (ORPHA:1125)
- Seizure (HP:0001250): A seizure is an intermittent abnormality of nervous system physiology characterized by a transient occurrence of signs and/or symptoms due to abnormal excessive or synchronous neuronal activity in the brain. Evidence: TAS. Frequency: Occasional (HP:0040283). (ORPHA:1125)
- Hypotonia (HP:0001252): Hypotonia is an abnormally low muscle tone (the amount of tension or resistance to movement in a muscle). Even when relaxed, muscles have a continuous and passive partial contraction which provides some resistance to passive stretching. Hypotonia thus manifests as diminished resistance to passive stretching. Hypotonia is not the same as muscle weakness, although the two conditions can co-exist. Evidence: TAS. Frequency: Occasional (HP:0040283). (ORPHA:1125)
- Clumsiness (HP:0002312): Lack of physical coordination resulting in an abnormal tendency to drop items or bump into objects. Evidence: TAS. Frequency: Occasional (HP:0040283). (ORPHA:1125)